Phenotypes associated with the disease Caudal duplication (ORPHA:1756):
- Cryptorchidism (HP:0000028): Testis in inguinal canal. That is, absence of one or both testes from the scrotum owing to failure of the testis or testes to descend through the inguinal canal to the scrotum. Evidence: TAS. Frequency: Occasional (HP:0040283). (ORPHA:1756)
- Abnormal penis morphology (HP:0000036): Abnormality of the male external sex organ. Evidence: TAS. Frequency: Frequent (HP:0040282). (ORPHA:1756)
- Ureteral duplication (HP:0000073): A developmental anomaly characterized by the presence of two, instead of one, ureter connecting a kidney to the bladder. Evidence: TAS. Frequency: Frequent (HP:0040282). (ORPHA:1756)
- Abnormality of the genital system (HP:0000078): An abnormality of the genital system. Evidence: TAS. Frequency: Frequent (HP:0040282). (ORPHA:1756)
- Omphalocele (HP:0001539): A midline anterior incomplete closure of the abdominal wall in which there is herniation of the abdominal viscera into the base of the abdominal cord. Evidence: TAS. Frequency: Occasional (HP:0040283). (ORPHA:1756)
- Spina bifida (HP:0002414): Incomplete closure of the embryonic neural tube, whereby some vertebral arches remain unfused and open. The mildest form is spina bifida occulta, followed by meningocele and meningomyelocele. Evidence: TAS. Frequency: Frequent (HP:0040282). (ORPHA:1756)
- Myelomeningocele (HP:0002475): Protrusion of the meninges and portions of the spinal cord through a defect of the vertebral column. Evidence: TAS. Frequency: Frequent (HP:0040282). (ORPHA:1756)
- Vertebral segmentation defect (HP:0003422): An abnormality related to a defect of vertebral separation during development. Evidence: TAS. Frequency: Frequent (HP:0040282). (ORPHA:1756)
- Uterus didelphys (HP:0003762): A malformation of the uterus in which the uterus is present as a paired organ as a result of the failure of fusion of the mullerian ducts during embryogenesis. Evidence: TAS. Frequency: Frequent (HP:0040282). (ORPHA:1756)
- Abnormal sacrum morphology (HP:0005107): An abnormality of the sacral bone. Evidence: TAS. Frequency: Frequent (HP:0040282). (ORPHA:1756)
- Renal hypoplasia/aplasia (HP:0008678): Absence or underdevelopment of the kidney. Evidence: TAS. Frequency: Frequent (HP:0040282). (ORPHA:1756)
- Bifid sacrum (HP:0009791): Presence of a bifid sacral bone. Evidence: TAS. Frequency: Frequent (HP:0040282). (ORPHA:1756)
- Spinal cord lesion (HP:0100561). Evidence: TAS. Frequency: Frequent (HP:0040282). (ORPHA:1756)
- Urogenital fistula (HP:0100589): The presence of a fistula affecting the genitourinary system. Evidence: TAS. Frequency: Occasional (HP:0040283). (ORPHA:1756)
- Intestinal duplication (HP:0100668): A developmental disorder in which there is a duplication the entire intestine or of a portion of the intestine. Evidence: TAS. Frequency: Frequent (HP:0040282). (ORPHA:1756)